- Cutaneous melanoma (HP:0012056): The presence of a melanoma of the skin. Evidence: TAS. (OMIM:155601)
- Autosomal dominant inheritance (HP:0000006): A mode of inheritance that is observed for traits related to a gene encoded on one of the autosomes (i.e., the human chromosomes 1-22) in which a trait manifests in heterozygotes. In the context of medical genetics, an autosomal dominant disorder is caused when a single copy of the mutant allele is present. Males and females are affected equally, and can both transmit the disorder with a risk of 50% for each child of inheriting the mutant allele. Evidence: TAS. (OMIM:155601)
These phenotypes are associated with the disease melanoma, cutaneous malignant, susceptibility to, 2 (OMIM:155601).